- Autosomal recessive inheritance (HP:0000007): A mode of inheritance that is observed for traits related to a gene encoded on one of the autosomes (i.e., the human chromosomes 1-22) in which a trait manifests in individuals with two pathogenic alleles, either homozygotes (two copies of the same mutant allele) or compound heterozygotes (whereby each copy of a gene has a distinct mutant allele). Evidence: PCS. (PMID:20671153)
This phenotype is associated with the disease Bardet-Biedl syndrome 15 (OMIM:615992).